- Bilateral tonic-clonic seizure (HP:0002069): A bilateral tonic-clonic seizure is a seizure defined by a tonic (bilateral increased tone, lasting seconds to minutes) and then a clonic (bilateral sustained rhythmic jerking) phase. Evidence: TAS. (OMIM:600669)
- EEG with spike-wave complexes (>3.5 Hz) (HP:0010849): The presence of complexes of spikes and waves (>3.5 Hz) in electroencephalography (EEG). Evidence: TAS. (OMIM:600669)
- Generalized myoclonic seizure (HP:0002123): A generalized myoclonic seizure is a type of generalized motor seizure characterized by bilateral, sudden, brief (<100 ms) involuntary single or multiple contraction of muscles or muscle groups of variable topography (axial, proximal limb, distal). Myoclonus is less regularly repetitive and less sustained than is clonus. Evidence: TAS. (OMIM:600669)
- Generalized non-motor (absence) seizure (HP:0002121): A generalized non-motor (absence) seizure is a type of a type of dialeptic seizure that is of electrographically generalized onset. It is a generalized seizure characterized by an interruption of activities, a blank stare, and usually the person will be unresponsive when spoken to. Any ictal motor phenomena are minor in comparison to these non-motor features. Evidence: TAS. (OMIM:600669)
- Autosomal dominant inheritance (HP:0000006): A mode of inheritance that is observed for traits related to a gene encoded on one of the autosomes (i.e., the human chromosomes 1-22) in which a trait manifests in heterozygotes. In the context of medical genetics, an autosomal dominant disorder is caused when a single copy of the mutant allele is present. Males and females are affected equally, and can both transmit the disorder with a risk of 50% for each child of inheriting the mutant allele. Evidence: TAS. (OMIM:600669)
These phenotypes are associated with the disease idiopathic generalized epilepsy (OMIM:600669).